- Abnormality of metabolism/homeostasis (HP:0001939). Evidence: IEA. (OMIM:124060)
- Autosomal dominant inheritance (HP:0000006): A mode of inheritance that is observed for traits related to a gene encoded on one of the autosomes (i.e., the human chromosomes 1-22) in which a trait manifests in heterozygotes. In the context of medical genetics, an autosomal dominant disorder is caused when a single copy of the mutant allele is present. Males and females are affected equally, and can both transmit the disorder with a risk of 50% for each child of inheriting the mutant allele. Evidence: IEA. (OMIM:124060)
These phenotypes are associated with the disease Cytochrome P450, subfamily I, polypeptide 2 (OMIM:124060).